Phenotypes associated with the disease Autoimmune polyendocrinopathy type 3 (ORPHA:227982):
- Autoimmunity (HP:0002960): The occurrence of an immune reaction against the organism's own cells or tissues. Evidence: TAS. Frequency: Obligate (HP:0040280). (ORPHA:227982)
- Hashimoto thyroiditis (HP:0000872): A chronic, autoimmune type of thyroiditis associated with hypothyroidism. Evidence: TAS. Frequency: Frequent (HP:0040282). (ORPHA:227982)
- Macrocytic anemia (HP:0001972): A type of anemia characterized by increased size of erythrocytes with increased mean corpuscular volume (MCV) and increased mean corpuscular hemoglobin (MCH). Evidence: TAS. Frequency: Frequent (HP:0040282). (ORPHA:227982)
- Atrophic gastritis (HP:0002582): Atrophic gastritis (AG) is a histopathological entity that is characterized by chronic inflammation of the gastric mucosa with loss of gastric glandular cells and replacement by intestinal-type epithelium, pyloric-type glands, and fibrous tissue. Evidence: TAS. Frequency: Frequent (HP:0040282). (ORPHA:227982)
- Celiac disease (HP:0002608): Celiac disease (CD) is an autoimmune condition affecting the small intestine, triggered by the ingestion of gluten, the protein fraction of wheat, barley, and rye. Clinical manifestations of CD are highly variable and include both gastrointestinal and non-gastrointestinal features. The hallmark of CD is an immune-mediated enteropathy. This term is included because the occurrence of CD is seen as a feature of a number of other diseases. Evidence: TAS. Frequency: Frequent (HP:0040282). (ORPHA:227982)
- Autoimmune antibody positivity (HP:0030057): The presence of an antibody in the blood circulation that is directed against the organism's own cells or tissues. Evidence: TAS. Frequency: Frequent (HP:0040282). (ORPHA:227982)
- Graves disease (HP:0100647): An autoimmune disease where the thyroid is overactive, producing an excessive amount of thyroid hormones (a serious metabolic imbalance known as hyperthyroidism and thyrotoxicosis). This is caused by autoantibodies to the TSH-receptor (TSHR-Ab) that activate that TSH-receptor (TSHR), thereby stimulating thyroid hormone synthesis and secretion, and thyroid growth (causing a diffusely enlarged goiter). The resulting state of hyperthyroidism can cause a dramatic constellation of neuropsychological and physical signs and symptoms, which can severely compromise the patients. Evidence: TAS. Frequency: Frequent (HP:0040282). (ORPHA:227982)
- Type I diabetes mellitus (HP:0100651): A chronic condition in which the pancreas produces little or no insulin. Type I diabetes mellitus is manifested by the sudden onset of severe hyperglycemia with rapid progression to diabetic ketoacidosis unless treated with insulin. Evidence: TAS. Frequency: Frequent (HP:0040282). (ORPHA:227982)
- Vitiligo (HP:0001045). Evidence: TAS. Frequency: Occasional (HP:0040283). (ORPHA:227982)
- Alopecia (HP:0001596): A noncongenital process of hair loss, which may progress to partial or complete baldness. Evidence: TAS. Frequency: Occasional (HP:0040283). (ORPHA:227982)
- Decreased total leukocyte count (HP:0001882): An abnormal decreased number of leukocytes in the blood. Evidence: TAS. Frequency: Occasional (HP:0040283). (ORPHA:227982)
- Biliary cirrhosis (HP:0002613): Progressive destruction of the small-to-medium bile ducts of the intrahepatic biliary tree, which leads to progressive cholestasis and often end-stage liver disease. Evidence: TAS. Frequency: Occasional (HP:0040283). (ORPHA:227982)
- Decreased circulating immunoglobulin concentration (HP:0004313): An abnormally decreased level of immunoglobulin in blood. Evidence: TAS. Frequency: Occasional (HP:0040283). (ORPHA:227982)
- Anterior pituitary dysgenesis (HP:0010625): Absence or underdevelopment of the anterior pituitary gland, also known as the adenohypophysis. Evidence: TAS. Frequency: Occasional (HP:0040283). (ORPHA:227982)
- Xerostomia (HP:0000217): Dryness of the mouth due to salivary gland dysfunction. Evidence: TAS. Frequency: Very rare (HP:0040284). (ORPHA:227982)
- Hypergonadotropic hypogonadism (HP:0000815): Reduced function of the gonads (testes in males or ovaries in females) associated with excess pituitary gonadotropin secretion and resulting in delayed sexual development and growth delay. Evidence: TAS. Frequency: Very rare (HP:0040284). (ORPHA:227982)
- Central diabetes insipidus (HP:0000863): A form of diabetes insipidus related to a failure of vasopressin (AVP) release from the hypothalamus. Evidence: TAS. Frequency: Very rare (HP:0040284). (ORPHA:227982)
- Osteopenia (HP:0000938): Osteopenia is a term to define bone density that is not normal but also not as low as osteoporosis. By definition from the World Health Organization osteopenia is defined by bone densitometry as a T score -1 to -2.5. Evidence: TAS. Frequency: Very rare (HP:0040284). (ORPHA:227982)
- Iridocyclitis (HP:0001094): A type of anterior uveitis, in which there is Inflammation of the iris and the ciliary body. Evidence: TAS. Frequency: Very rare (HP:0040284). (ORPHA:227982)
- Keratoconjunctivitis sicca (HP:0001097): Dryness of the eye related to deficiency of the tear film components (aqueous, mucin, or lipid), lid surface abnormalities, or epithelial abnormalities. Keratoconjunctivitis sicca often results in a scratchy or sandy sensation (foreign body sensation) in the eyes, and may also be associated with itching, inability to produce tears, photosensitivity, redness, pain, and difficulty in moving the eyelids. Evidence: TAS. Frequency: Very rare (HP:0040284). (ORPHA:227982)
- Rheumatoid arthritis (HP:0001370): Inflammatory changes in the synovial membranes and articular structures with widespread fibrinoid degeneration of the collagen fibers in mesenchymal tissues, as well as atrophy and rarefaction of bony structures. Evidence: TAS. Frequency: Very rare (HP:0040284). (ORPHA:227982)
- Tubulointerstitial nephritis (HP:0001970): A form of inflammation of the kidney affecting the interstitium of the kidneys surrounding the tubules. Evidence: TAS. Frequency: Very rare (HP:0040284). (ORPHA:227982)
- Autoimmune thrombocytopenia (HP:0001973): The presence of thrombocytopenia in combination with detection of antiplatelet antibodies. Evidence: TAS. Frequency: Very rare (HP:0040284). (ORPHA:227982)
- Antiphospholipid antibody positivity (HP:0003613): The presence of circulating autoantibodies to phospholipids. Evidence: TAS. Frequency: Very rare (HP:0040284). (ORPHA:227982)
- Abnormal pulmonary interstitial morphology (HP:0006530): Abnormality of the lung parenchyma extending to the pulmonary interstitium and leading to diffuse pulmonary fibrosis. Evidence: TAS. Frequency: Very rare (HP:0040284). (ORPHA:227982)
- Abnormal blistering of the skin (HP:0008066): The presence of one or more bullae on the skin, defined as fluid-filled blisters more than 5 mm in diameter with thin walls. Evidence: TAS. Frequency: Very rare (HP:0040284). (ORPHA:227982)
- Aplasia/Hypoplasia of the spleen (HP:0010451): Absence or underdevelopment of the spleen. Evidence: TAS. Frequency: Very rare (HP:0040284). (ORPHA:227982)
- Autoimmune hypoparathyroidism (HP:0011771): A type of hypoparathyroidism with circulating antiparathyroid or anti-calcium sensing receptor antibodies indicative of autoimmunity. Evidence: TAS. Frequency: Very rare (HP:0040284). (ORPHA:227982)
- Hepatitis (HP:0012115): Inflammation of the liver. Evidence: TAS. Frequency: Very rare (HP:0040284). (ORPHA:227982)
- Non-caseating epithelioid cell granulomatosis (HP:0012220): The presence of multiple epithelioid cell granulomas consist of highly differentiated mononuclear phagocytes (epithelioid cells and giant cells) and lymphocytes, not exhibiting caseation (a form of necrosis in which the tissue changes into a dry, amorphous mass said to resemble cheese). Evidence: TAS. Frequency: Very rare (HP:0040284). (ORPHA:227982)
- Thymoma (HP:0100522): A tumor originating from the epithelial cells of the thymus. Evidence: TAS. Frequency: Very rare (HP:0040284). (ORPHA:227982)
Not associated with this disease:
- Recurrent mucocutaneous candidiasis (HP:0002728): Recurrent or persistent superficial Candida infections of the skin, mucous membranes, and nails. Evidence: TAS. (ORPHA:227982)
- Primary adrenal insufficiency (HP:0008207): Insufficient production of steroid hormones (primarily cortisol) by the adrenal glands as a result of a primary defect in the glands themselves. Evidence: TAS. (ORPHA:227982)